Phenotypes associated with the disease Reese retinal dysplasia (OMIM:266400):
- Remnants of the hyaloid vascular system (HP:0007968): Persistence of the hyaloid artery, which is the embryonic artery that runs from the optic disc to the posterior lens capsule may persist; the site of attachment may form an opacity. The hyaloid artery is a branch of the ophthalmic artery, and usually regresses completely before birth. This features results from a failure of regression of the hyaloid vessel, which supplies the primary vitreous during embryogenesis and normally regresses in the third trimester of pregnancy, leading to a particular form of posterior cataract. Evidence: TAS. (OMIM:266400)
- Autosomal recessive inheritance (HP:0000007): A mode of inheritance that is observed for traits related to a gene encoded on one of the autosomes (i.e., the human chromosomes 1-22) in which a trait manifests in individuals with two pathogenic alleles, either homozygotes (two copies of the same mutant allele) or compound heterozygotes (whereby each copy of a gene has a distinct mutant allele). Evidence: TAS. (OMIM:266400)
- Retinal dysplasia (HP:0007973): Abnormal growth and differentiation, structure and appearance of the retina present from birth. Evidence: TAS. (OMIM:266400)